Phenotypes associated with the disease X-linked intellectual disability, Seemanova type (ORPHA:85323):
- Cryptorchidism (HP:0000028): Testis in inguinal canal. That is, absence of one or both testes from the scrotum owing to failure of the testis or testes to descend through the inguinal canal to the scrotum. Evidence: TAS. Frequency: Frequent (HP:0040282). (ORPHA:85323)
- Hypogonadism (HP:0000135): A decreased functionality of the gonad. Evidence: TAS. Frequency: Frequent (HP:0040282). (ORPHA:85323)
- Microcephaly (HP:0000252): Head circumference below 2 standard deviations below the mean for age and gender. Evidence: TAS. Frequency: Frequent (HP:0040282). (ORPHA:85323)
- Retrognathia (HP:0000278): An abnormality in which the mandible is mislocalised posteriorly. Evidence: TAS. Frequency: Frequent (HP:0040282). (ORPHA:85323)
- Epicanthus (HP:0000286): A fold of skin starting above the medial aspect of the upper eyelid and arching downward to cover, pass in front of and lateral to the medial canthus. Evidence: TAS. Frequency: Frequent (HP:0040282). (ORPHA:85323)
- Hypertelorism (HP:0000316): Interpupillary distance more than 2 SD above the mean (alternatively, the appearance of an increased interpupillary distance or widely spaced eyes). Evidence: TAS. Frequency: Frequent (HP:0040282). (ORPHA:85323)
- Macrotia (HP:0000400): Median longitudinal ear length greater than two standard deviations above the mean and median ear width greater than two standard deviations above the mean (objective); or, apparent increase in length and width of the pinna (subjective). Evidence: TAS. Frequency: Frequent (HP:0040282). (ORPHA:85323)
- Developmental cataract (HP:0000519): A cataract that occurs congenitally as the result of a developmental defect, in contrast to the majority of cataracts that occur in adulthood as the result of degenerative changes of the lens. Evidence: TAS. Frequency: Frequent (HP:0040282). (ORPHA:85323)
- Intellectual disability (HP:0001249): The term intellectual disability or intellectual developmental disorder is used to describe significantly sub-average intellectual and adaptive functioning based on clinical assessment and as measured by individually administered, appropriately normed, standardized and validated tests of intellectual functioning and adaptive behavior, with onset during the developmental period from infancy through adolescence. Evidence: TAS. Frequency: Frequent (HP:0040282). (ORPHA:85323)
- Seizure (HP:0001250): A seizure is an intermittent abnormality of nervous system physiology characterized by a transient occurrence of signs and/or symptoms due to abnormal excessive or synchronous neuronal activity in the brain. Evidence: TAS. Frequency: Frequent (HP:0040282). (ORPHA:85323)
- Small for gestational age (HP:0001518): Smaller than normal size according to sex and gestational age related norms, defined as a weight below the 10th percentile for the gestational age. Evidence: TAS. Frequency: Frequent (HP:0040282). (ORPHA:85323)
- Progressive spasticity (HP:0002191): Spasticity that increases in degree with time. Evidence: TAS. Frequency: Frequent (HP:0040282). (ORPHA:85323)
- Skeletal muscle atrophy (HP:0003202): The presence of skeletal muscular atrophy (which is also known as amyotrophy). Evidence: TAS. Frequency: Frequent (HP:0040282). (ORPHA:85323)
- Hypoplasia of the musculature (HP:0009004): Underdevelopment of the musculature. Evidence: TAS. Frequency: Frequent (HP:0040282). (ORPHA:85323)
- High palate (HP:0000218): Height of the palate more than 2 SD above the mean (objective) or palatal height at the level of the first permanent molar more than twice the height of the teeth (subjective). Evidence: TAS. Frequency: Occasional (HP:0040283). (ORPHA:85323)
- Abnormal heart morphology (HP:0001627): Any structural anomaly of the heart. Evidence: TAS. Frequency: Occasional (HP:0040283). (ORPHA:85323)